Phenotypes associated with the disease combined oxidative phosphorylation deficiency 50 (OMIM:619025):
- Delayed ability to roll over (HP:0032989): Delayed achievement of the ability to roll front to back and back to front. Evidence: PCS. Frequency: 1/1. (PMID:31039582)
- Poor head control (HP:0002421): Difficulty to maintain correct position of the head while standing or sitting. Infant head lag is observed when the head seems to flop around or lags posteriorly behind the trunk. Several articles have maintained that head lag should be absent by age 3 to 4 months. Evidence: PCS. Frequency: 1/1. (PMID:31039582)
- Hip dysplasia (HP:0001385): The presence of developmental dysplasia of the hip. Evidence: PCS. Frequency: 1/1. (PMID:31039582)
- Microcephaly (HP:0000252): Head circumference below 2 standard deviations below the mean for age and gender. Evidence: PCS. Frequency: 1/1. (PMID:31039582)
- Dysphagia (HP:0002015): Difficulty in swallowing. Evidence: PCS. Frequency: 1/1. (PMID:31039582)
- Delayed ability to walk (HP:0031936): A failure to achieve the ability to walk at an appropriate developmental stage. Most children learn to walk in a series of stages, and learn to walk short distances independently between 12 and 15 months. Evidence: PCS. Frequency: 1/1. (PMID:31039582)
- Short stature (HP:0004322): A height below that which is expected according to age and gender norms. Although there is no universally accepted definition of short stature, many refer to "short stature" as height more than 2 standard deviations below the mean for age and gender (or below the 3rd percentile for age and gender dependent norms). Evidence: PCS. Frequency: 1/1. (PMID:31039582)
- Global developmental delay (HP:0001263): A delay in the achievement of motor or mental milestones in the domains of development of a child, including motor skills, speech and language, cognitive skills, and social and emotional skills. This term should only be used to describe children younger than five years of age. Evidence: PCS. Frequency: 1/1. (PMID:31039582)
- Infantile onset (HP:0003593): Onset of signs or symptoms of disease between 28 days to one year of life. Evidence: PCS. Frequency: 1/1. (PMID:31039582)
- Motor delay (HP:0001270): A type of Developmental delay characterized by a delay in acquiring motor skills. Evidence: PCS. Frequency: 1/1. (PMID:31039582)
- Delayed ability to crawl (HP:0033128): A failure to achieve the ability to crawl at an appropriate developmental stage. Normal infant motor development is marked by a series of postural milestones including learning to crawl on hands and knees between the ages of 6 and 10 months. Evidence: PCS. Frequency: 1/1. (PMID:31039582)
- Autosomal recessive inheritance (HP:0000007): A mode of inheritance that is observed for traits related to a gene encoded on one of the autosomes (i.e., the human chromosomes 1-22) in which a trait manifests in individuals with two pathogenic alleles, either homozygotes (two copies of the same mutant allele) or compound heterozygotes (whereby each copy of a gene has a distinct mutant allele). Evidence: PCS. (PMID:31039582)
- Partial agenesis of the corpus callosum (HP:0001338): A partial failure of the development of the corpus callosum. Evidence: PCS. Frequency: 1/1. (PMID:31039582)
- Adrenal insufficiency (HP:0000846): Insufficient production of steroid hormones (primarily cortisol) by the adrenal glands. Evidence: PCS. Frequency: 1/1. (PMID:31039582)
- Decreased activity of mitochondrial complex IV (HP:0008347): A reduction in the activity of the mitochondrial respiratory chain complex IV, which is part of the electron transport chain in mitochondria. Evidence: PCS. Frequency: 1/1. (PMID:31039582)
- Intrauterine growth retardation (HP:0001511): An abnormal restriction of fetal growth with fetal weight below the tenth percentile for gestational age. Evidence: PCS. Frequency: 1/1. (PMID:31039582)
- Generalized dystonia (HP:0007325): A type of dystonia that affects all or most of the body. Evidence: PCS. Frequency: 1/1. (PMID:31039582)
- Brisk reflexes (HP:0001348): Tendon reflexes that are noticeably more active than usual (conventionally denoted 3+ on clinical examination). Brisk reflexes may or may not indicate a neurological lesion. They are distinguished from hyperreflexia by the fact that hyerreflexia is characterized by hyperactive repeating (clonic) reflexes, which are considered to be always abnormal. Evidence: PCS. Frequency: 1/1. (PMID:31039582)